- Broad-based gait (HP:0002136): An abnormal gait pattern in which persons stand and walk with their feet spaced widely apart. This is often a component of cerebellar ataxia. Evidence: IEA. (OMIM:605388)
- Cerebellar atrophy (HP:0001272): Cerebellar atrophy is defined as a cerebellum with initially normal structures, in a posterior fossa with normal size, which displays enlarged fissures (interfolial spaces) in comparison to the foliae secondary to loss of tissue. Cerebellar atrophy implies irreversible loss of tissue and result from an ongoing progressive disease until a final stage is reached or a single injury, e.g. an intoxication or infectious event. Evidence: IEA. (OMIM:605388)
- Dysarthria (HP:0001260): Dysarthric speech is a general description referring to a neurological speech disorder characterized by poor articulation. Depending on the involved neurological structures, dysarthria may be further classified as spastic, flaccid, ataxic, hyperkinetic and hypokinetic, or mixed. Evidence: IEA. (OMIM:605388)
- Dysdiadochokinesis (HP:0002075): A type of ataxia characterized by the impairment of the ability to perform rapidly alternating movements, such as pronating and supinating his or her hand on the dorsum of the other hand as rapidly as possible. Evidence: IEA. (OMIM:605388)
- Infantile onset (HP:0003593): Onset of signs or symptoms of disease between 28 days to one year of life. Evidence: IEA. (OMIM:605388)
- Autosomal recessive inheritance (HP:0000007): A mode of inheritance that is observed for traits related to a gene encoded on one of the autosomes (i.e., the human chromosomes 1-22) in which a trait manifests in individuals with two pathogenic alleles, either homozygotes (two copies of the same mutant allele) or compound heterozygotes (whereby each copy of a gene has a distinct mutant allele). Evidence: IEA. (OMIM:605388)
- Cerebral palsy (HP:0100021): Cerebral palsy describes a group of permanent disorders of the development of movement and posture, causing activity limitation, that are attributed to nonprogressive disturbances that occurred in the developing fetal or infant brain. The motor disorders of cerebral palsy are often accompanied by disturbances of sensation, perception, cognition, communication, and behavior, by epilepsy, and by secondary musculoskeletal problems. Evidence: IEA. (OMIM:605388)
- Motor delay (HP:0001270): A type of Developmental delay characterized by a delay in acquiring motor skills. Evidence: IEA. (OMIM:605388)
- Horizontal nystagmus (HP:0000666): Nystagmus consisting of horizontal to-and-fro eye movements. Evidence: IEA. (OMIM:605388)
These phenotypes are associated with the disease cerebral palsy, ataxic, autosomal recessive (OMIM:605388).